- Abnormal pancreas morphology (HP:0012090). Evidence: TAS. Frequency: Occasional (HP:0040283). (ORPHA:449432)
- Pharyngitis (HP:0025439): Inflammation (due to infection or irritation) of the pharynx. Evidence: TAS. Frequency: Occasional (HP:0040283). (ORPHA:449432)
- Periorbital edema (HP:0100539): Edema affecting the region situated around the orbit of the eye. Evidence: TAS. Frequency: Occasional (HP:0040283). (ORPHA:449432)
- Prostatitis (HP:0000024): The presence of inflammation of the prostate. Evidence: TAS. Frequency: Very rare (HP:0040284). (ORPHA:449432)
- Abnormal bronchus morphology (HP:0025426): Any structural anomaly of the bronchi, i.e., of the airways leading from the trachea to the lungs. Evidence: TAS. Frequency: Very rare (HP:0040284). (ORPHA:449432)
- Autoimmunity (HP:0002960): The occurrence of an immune reaction against the organism's own cells or tissues. Evidence: TAS. Frequency: Very frequent (HP:0040281). (ORPHA:449432)
- Increased circulating IgG concentration (HP:0003237): An abnormally increased level of immunoglobulin G in blood. Evidence: TAS. Frequency: Very frequent (HP:0040281). (ORPHA:449432)
- Abnormality of the submandibular glands (HP:0010287): Any abnormality of the submandibular glands, which are the salivary glands that are located beneath the floor of the mouth, superior to the digastric muscles. Evidence: TAS. Frequency: Very frequent (HP:0040281). (ORPHA:449432)
- Increased circulating IgG4 concentration (HP:0032300): An abnormally increased concentration of the IgG4 subtype in the blood circulation. Evidence: TAS. Frequency: Very frequent (HP:0040281). (ORPHA:449432)
- Xerostomia (HP:0000217): Dryness of the mouth due to salivary gland dysfunction. Evidence: TAS. Frequency: Frequent (HP:0040282). (ORPHA:449432)
- Increased total eosinophil count (HP:0001880): Increased count of eosinophils in the blood. Evidence: TAS. Frequency: Frequent (HP:0040282). (ORPHA:449432)
- Lymphadenopathy (HP:0002716): Enlargement (swelling) of a lymph node. Evidence: TAS. Frequency: Frequent (HP:0040282). (ORPHA:449432)
- Increased circulating IgE concentration (HP:0003212): An abnormally increased overall level of immunoglobulin E in blood. Evidence: TAS. Frequency: Frequent (HP:0040282). (ORPHA:449432)
- Reduced circulating complement concentration (HP:0004431): An immunodeficiency defined by the absent or suboptimal functioning of one of the complement system proteins. Evidence: TAS. Frequency: Frequent (HP:0040282). (ORPHA:449432)
- Enlarged lacrimal glands (HP:0007734): Abnormally big lacrimal glands. Evidence: TAS. Frequency: Frequent (HP:0040282). (ORPHA:449432)
- Abnormal salivary gland morphology (HP:0010286): Any abnormality of the salivary glands, the exocrine glands that produce saliva. Evidence: TAS. Frequency: Frequent (HP:0040282). (ORPHA:449432)
- Increased circulating immunoglobulin concentration (HP:0010702): An increased level of gamma globulin (immunoglobulin) in the blood. Evidence: TAS. Frequency: Frequent (HP:0040282). (ORPHA:449432)
- Sialadenitis (HP:0031281): Inflammation of a salivary gland. Evidence: TAS. Frequency: Frequent (HP:0040282). (ORPHA:449432)
- Abnormality of the kidney (HP:0000077): An abnormality of the kidney. Evidence: TAS. Frequency: Occasional (HP:0040283). (ORPHA:449432)
- Renal insufficiency (HP:0000083): A reduction in the level of performance of the kidneys in areas of function comprising the concentration of urine, removal of wastes, the maintenance of electrolyte balance, homeostasis of blood pressure, and calcium metabolism. Evidence: TAS. Frequency: Occasional (HP:0040283). (ORPHA:449432)
- Facial edema (HP:0000282). Evidence: TAS. Frequency: Occasional (HP:0040283). (ORPHA:449432)
- Abnormality of the thyroid gland (HP:0000820): An abnormality of the thyroid gland. Evidence: TAS. Frequency: Occasional (HP:0040283). (ORPHA:449432)
- Retroperitoneal fibrosis (HP:0005200). Evidence: TAS. Frequency: Occasional (HP:0040283). (ORPHA:449432)
- Enlargement of parotid gland (HP:0011801): Increased size of the parotid gland. Evidence: TAS. Frequency: Occasional (HP:0040283). (ORPHA:449432)
- Cholangitis (HP:0030151): Inflammation of the biliary ductal system, affecting the intrahepatic or extrahepatic portions, or both. Evidence: TAS. Frequency: Very rare (HP:0040284). (ORPHA:449432)
These phenotypes are associated with the disease IgG4-related submandibular gland disease (ORPHA:449432).